- Decreased fertility (HP:0000144). Evidence: TAS. Frequency: Very frequent (HP:0040281). (ORPHA:3471)
- Recurrent bronchitis (HP:0002837): An increased susceptibility to bronchitis as manifested by a history of recurrent bronchitis. Evidence: TAS. Frequency: Very frequent (HP:0040281). (ORPHA:3471)
- Recurrent sinopulmonary infections (HP:0005425): An increased susceptibility to infections involving both the paranasal sinuses and the lungs, as manifested by a history of recurrent sinopulmonary infections. Evidence: TAS. Frequency: Very frequent (HP:0040281). (ORPHA:3471)
- Obstructive azoospermia (HP:0011962): Absence of any measurable level of sperm in his semen, resulting from post-testicular obstruction or retrograde ejaculation. This can be differentiated from obstructive azoospermia on the basis of testicular biopsy. Evidence: TAS. Frequency: Very frequent (HP:0040281). (ORPHA:3471)
- Recurrent otitis media (HP:0000403): Increased susceptibility to otitis media, as manifested by recurrent episodes of otitis media. Evidence: TAS. Frequency: Frequent (HP:0040282). (ORPHA:3471)
- Bronchiectasis (HP:0002110): Persistent abnormal dilatation of the bronchi owing to localized and irreversible destruction and widening of the large airways. Evidence: TAS. Frequency: Frequent (HP:0040282). (ORPHA:3471)
- Chronic rhinitis (HP:0002257): Chronic inflammation of the nasal mucosa. Evidence: TAS. Frequency: Frequent (HP:0040282). (ORPHA:3471)
- Airway obstruction (HP:0006536): Obstruction of conducting airways of the lung. Evidence: TAS. Frequency: Frequent (HP:0040282). (ORPHA:3471)
- Chronic sinusitis (HP:0011109): A chronic form of sinusitis. Evidence: TAS. Frequency: Frequent (HP:0040282). (ORPHA:3471)
- Reduced forced vital capacity (HP:0032341): An abnormal reduction in the amount of air a person can expel following maximal inspiration. Evidence: TAS. Frequency: Frequent (HP:0040282). (ORPHA:3471)
- Chronic cough (HP:0034315): A persistent cough, defined as a cough lasting longer than eight weeks in adults or longer than four weeks in children. Evidence: TAS. Frequency: Frequent (HP:0040282). (ORPHA:3471)
- Nasal polyposis (HP:0100582): Polypoidal masses arising mainly from the mucous membranes of the nose and paranasal sinuses. They are freely movable and nontender overgrowths of the mucosa that frequently accompany allergic rhinitis. Evidence: TAS. Frequency: Frequent (HP:0040282). (ORPHA:3471)
- Hearing impairment (HP:0000365): A decreased magnitude of the sensory perception of sound. Evidence: TAS. Frequency: Occasional (HP:0040283). (ORPHA:3471)
- Male infertility (HP:0003251). Evidence: TAS. Frequency: Occasional (HP:0040283). (ORPHA:3471)
These phenotypes are associated with the disease Young syndrome (ORPHA:3471).